Phenotypes associated with the disease congenital stationary night blindness 1G (OMIM:616389):
- Constriction of peripheral visual field (HP:0001133): An absolute or relative decrease in retinal sensitivity extending from edge (periphery) of the visual field in a concentric pattern. The visual field is the area that is perceived simultaneously by a fixating eye. Evidence: PCS. Frequency: 1/1. (PMID:26472407)
- Autosomal recessive inheritance (HP:0000007): A mode of inheritance that is observed for traits related to a gene encoded on one of the autosomes (i.e., the human chromosomes 1-22) in which a trait manifests in individuals with two pathogenic alleles, either homozygotes (two copies of the same mutant allele) or compound heterozygotes (whereby each copy of a gene has a distinct mutant allele). Evidence: PCS. (PMID:22190596)
- Early-onset non-progressive night blindness (HP:0007642): A usually nonprogressive (i.e., stationary) form of night blindness with early (presumed to be congenital) onset. Evidence: PCS. Frequency: 4/4. Onset: Childhood onset (HP:0011463). (PMID:22190596)
- Early-onset non-progressive night blindness (HP:0007642): A usually nonprogressive (i.e., stationary) form of night blindness with early (presumed to be congenital) onset. Evidence: PCS. Frequency: 1/1. (PMID:26472407)
- Visual impairment (HP:0000505): Visual impairment (or vision impairment) is vision loss (of a person) to such a degree as to qualify as an additional support need through a significant limitation of visual capability resulting from either disease, trauma, or congenital or degenerative conditions that cannot be corrected by conventional means, such as refractive correction, medication, or surgery. Evidence: PCS. Frequency: 0/4. (PMID:22190596)
- Optic disc pallor (HP:0000543): A pale yellow discoloration of the optic disc (the area of the optic nerve head in the retina). The optic disc normally has a pinkish hue with a central yellowish depression. Evidence: PCS. Frequency: 1/1. (PMID:26472407)
- Rod-cone dystrophy (HP:0000510): An inherited retinal disease subtype in which the rod photoreceptors appear to be more severely affected than the cone photoreceptors. Typical presentation is with nyctalopia (due to rod dysfunction) followed by loss of mid-peripheral field of vision, which gradually extends and leaves many patients with a small central island of vision due to the preservation of macular cones. Evidence: PCS. Frequency: 1/1. (PMID:26472407)